Phenotypes associated with the disease complex cortical dysplasia with other brain malformations 2 (OMIM:615282):
- Hypertonia (HP:0001276): A condition in which there is increased muscle tone so that arms or legs, for example, are stiff and difficult to move. Evidence: PCS. Frequency: 1/1. (PMID:23033978)
- Spastic tetraplegia (HP:0002510): Spastic paralysis affecting all four limbs. Evidence: PCS. Frequency: 1/1. (PMID:23603762)
- Microcephaly (HP:0000252): Head circumference below 2 standard deviations below the mean for age and gender. Evidence: PCS. Frequency: 1/1. Onset: Congenital onset (HP:0003577). (PMID:23603762)
- Short foot (HP:0001773): A measured foot length that is more than 2 SD below the mean for a newborn of 27 - 41 weeks gestation, or foot that is less than the 3rd centile for individuals from birth to 16 years of age (objective). Alternatively, a foot that appears disproportionately short (subjective). Evidence: PCS. Frequency: 1/1. (PMID:23033978)
- Absent speech (HP:0001344): Complete lack of development of speech and language abilities. Evidence: PCS. Frequency: 1/1. (PMID:23033978)
- Hypoplasia of the corpus callosum (HP:0002079): Underdevelopment of the corpus callosum. Evidence: PCS. Frequency: 1/1. (PMID:23603762)
- Seizure (HP:0001250): A seizure is an intermittent abnormality of nervous system physiology characterized by a transient occurrence of signs and/or symptoms due to abnormal excessive or synchronous neuronal activity in the brain. Evidence: PCS. Frequency: 1/1. (PMID:23033978)
- Global developmental delay (HP:0001263): A delay in the achievement of motor or mental milestones in the domains of development of a child, including motor skills, speech and language, cognitive skills, and social and emotional skills. This term should only be used to describe children younger than five years of age. Evidence: PCS. (PMID:23033978)
- Secondary microcephaly (HP:0005484): Head circumference which falls below 2 standard deviations below the mean for age and gender because of insufficient head growth after birth. Evidence: PCS. Frequency: 1/1. (PMID:23033978)
- Severe intellectual disability (HP:0010864): Severe intellectual disability (ID) is defined as a type of ID characterized by severely sub-average adaptive functioning and intellectual functioning, with an intelligence quotient (IQ) the range of 20-34. Evidence: PCS. Frequency: 1/1. (PMID:23033978)
- Fetal onset (HP:0011461): Onset prior to birth but after 8 weeks of embryonic development (corresponding to a gestational age of 10 weeks). Evidence: PCS. Frequency: 4/4. (PMID:23603762)
- Cortical dysplasia (HP:0002539): The presence of developmental dysplasia of the cerebral cortex. Evidence: PCS. (PMID:23033978)
- Motor stereotypy (HP:0000733): Use of the same abnormal action in response to certain triggers or at random. They may be used as a way to regulate one's internal state but must otherwise have no apparent functional purpose. Evidence: PCS. Frequency: 1/1. (PMID:23033978)
- Clonic seizure (HP:0020221): A clonic seizure is a type of motor seizure characterized by sustained rhythmic jerking, that is regularly repetitive. Evidence: PCS. Frequency: 1/1. (PMID:23603762)
- Arthrogryposis multiplex congenita (HP:0002804): Multiple congenital contractures in different body areas. Evidence: PCS. Frequency: 1/1. Onset: Fetal onset (HP:0011461). (PMID:23603762)
- Self-injurious behavior (HP:0100716): Self-aggression. Evidence: PCS. Frequency: 1/1. (PMID:23033978)
- Fetal akinesia sequence (HP:0001989): Decreased fetal activity associated with multiple joint contractures, facial anomalies and pulmonary hypoplasia. Ultrasound examination may reveal polyhydramnios, ankylosis, scalp edema, and decreased chest movements (reflecting pulmonary hypoplasia). Evidence: PCS. Frequency: 3/3. Onset: Fetal onset (HP:0011461). (PMID:23603762)
- Small hand (HP:0200055): Disproportionately small hand. Evidence: PCS. Frequency: 1/1. (PMID:23033978)
- Intrauterine growth retardation (HP:0001511): An abnormal restriction of fetal growth with fetal weight below the tenth percentile for gestational age. Evidence: PCS. Frequency: 1/1. Onset: Fetal onset (HP:0011461). (PMID:23603762)
- Polymicrogyria (HP:0002126): Polymicrogyria is a congenital malformation of the cerebral cortex characterized by abnormal cortical layering (lamination) and an excessive number of small gyri (folds). Evidence: PCS. Frequency: 4/4. (PMID:23603762)
- Autosomal dominant inheritance (HP:0000006): A mode of inheritance that is observed for traits related to a gene encoded on one of the autosomes (i.e., the human chromosomes 1-22) in which a trait manifests in heterozygotes. In the context of medical genetics, an autosomal dominant disorder is caused when a single copy of the mutant allele is present. Males and females are affected equally, and can both transmit the disorder with a risk of 50% for each child of inheriting the mutant allele. Evidence: PCS. (PMID:23603762)